Phenotypes associated with the disease testicular microlithiasis (OMIM:610441):
- Testicular microlithiasis (HP:0012215): The deposition of calcium phosphate microliths within the seminiferous tubules. Evidence: TAS. (PMID:16960801)